Phenotypes associated with the disease Tessadori-van Haaften neurodevelopmental syndrome 2 (OMIM:619759, an entry in Online Mendelian Inheritance in Man):
- Highly arched eyebrow (HP:0002553, a Human Phenotype Ontology term): Increased height of the central portion of the eyebrow, forming a crescent, semicircular, or inverted U shape. Evidence: PCS. Frequency: 1/1. (PMID:31804630)
- Skeletal muscle atrophy (HP:0003202, a Human Phenotype Ontology term): The presence of skeletal muscular atrophy (which is also known as amyotrophy). Evidence: PCS. Frequency: 1/1. (PMID:31804630)
- Wide mouth (HP:0000154, a Human Phenotype Ontology term): Distance between the oral commissures more than 2 SD above the mean. Alternatively, an apparently increased width of the oral aperture (subjective). Evidence: PCS. Frequency: 1/1. (PMID:31804630)
- Upslanted palpebral fissure (HP:0000582, a Human Phenotype Ontology term): The palpebral fissure inclination is more than two standard deviations above the mean for age (objective); or, the inclination of the palpebral fissure is greater than typical for age. Evidence: PCS. Frequency: 1/1. (PMID:31804630)
- Congenital onset (HP:0003577, a Human Phenotype Ontology term): A phenotypic abnormality that is present at birth. Evidence: PCS. Frequency: 1/1. (PMID:31804630)
- Absent speech (HP:0001344, a Human Phenotype Ontology term): Complete lack of development of speech and language abilities. Evidence: PCS. Frequency: 1/1. (PMID:31804630)
- Delayed speech and language development (HP:0000750, a Human Phenotype Ontology term): A degree of language development that is significantly below the norm for a child of a specified age. Evidence: PCS. Frequency: 1/1. (PMID:31804630)
- Short stature (HP:0004322, a Human Phenotype Ontology term): A height below that which is expected according to age and gender norms. Although there is no universally accepted definition of short stature, many refer to "short stature" as height more than 2 standard deviations below the mean for age and gender (or below the 3rd percentile for age and gender dependent norms). Evidence: PCS. Frequency: 1/1. (PMID:31804630)
- Hypotonia (HP:0001252, a Human Phenotype Ontology term): Hypotonia is an abnormally low muscle tone (the amount of tension or resistance to movement in a muscle). Even when relaxed, muscles have a continuous and passive partial contraction which provides some resistance to passive stretching. Hypotonia thus manifests as diminished resistance to passive stretching. Hypotonia is not the same as muscle weakness, although the two conditions can co-exist. Evidence: PCS. Frequency: 1/1. (PMID:31804630)
- Global developmental delay (HP:0001263, a Human Phenotype Ontology term): A delay in the achievement of motor or mental milestones in the domains of development of a child, including motor skills, speech and language, cognitive skills, and social and emotional skills. This term should only be used to describe children younger than five years of age. Evidence: PCS. Frequency: 1/1. (PMID:31804630)
- Depressed nasal bridge (HP:0005280, a Human Phenotype Ontology term): Posterior positioning of the nasal root in relation to the overall facial profile for age. Evidence: PCS. Frequency: 1/1. (PMID:31804630)
- Autistic behavior (HP:0000729, a Human Phenotype Ontology term): Persistent deficits in social interaction and communication and interaction as well as a markedly restricted repertoire of activity and interest as well as repetitive patterns of behavior. Evidence: PCS. Frequency: 1/1. (PMID:31804630)
- Periorbital fullness (HP:0000629, a Human Phenotype Ontology term): Increase in periorbital soft tissue. Evidence: PCS. Frequency: 1/1. (PMID:31804630)
- Hypertelorism (HP:0000316, a Human Phenotype Ontology term): Interpupillary distance more than 2 SD above the mean (alternatively, the appearance of an increased interpupillary distance or widely spaced eyes). Evidence: PCS. Frequency: 1/1. (PMID:31804630)
- Oculomotor apraxia (HP:0000657, a Human Phenotype Ontology term): Ocular motor apraxia is a deficiency in voluntary, horizontal, lateral, fast eye movements (saccades) with retention of slow pursuit movements. The inability to follow objects visually is often compensated by head movements. There may be decreased smooth pursuit, and cancelation of the vestibulo-ocular reflex. Evidence: PCS. Frequency: 1/1. (PMID:31804630)
- Downturned corners of mouth (HP:0002714, a Human Phenotype Ontology term): A morphological abnormality of the mouth in which the angle of the mouth is downturned. The oral commissures are positioned inferior to the midline labial fissure. Evidence: PCS. Frequency: 1/1. (PMID:31804630)
- Esotropia (HP:0000565, a Human Phenotype Ontology term): A form of strabismus with one or both eyes turned inward ('crossed') to a relatively severe degree, usually defined as 10 diopters or more. Evidence: PCS. Frequency: 1/1. (PMID:31804630)
- Short philtrum (HP:0000322, a Human Phenotype Ontology term): Distance between nasal base and midline upper lip vermilion border more than 2 SD below the mean. Alternatively, an apparently decreased distance between nasal base and midline upper lip vermilion border. Evidence: PCS. Frequency: 1/1. (PMID:31804630)
- Growth delay (HP:0001510, a Human Phenotype Ontology term): A deficiency or slowing down of growth pre- and postnatally. Evidence: PCS. Frequency: 1/1. (PMID:31804630)
- Pes planus (HP:0001763, a Human Phenotype Ontology term): A foot where the longitudinal arch of the foot is in contact with the ground or floor when the individual is standing; or, in a patient lying supine, a foot where the arch is in contact with the surface of a flat board pressed against the sole of the foot by the examiner with a pressure similar to that expected from weight bearing; or, the height of the arch is reduced. Evidence: PCS. Frequency: 1/1. (PMID:31804630)
- Hypospadias (HP:0000047, a Human Phenotype Ontology term): Abnormal position of urethral meatus on the ventral penile shaft (underside) characterized by displacement of the urethral meatus from the tip of the glans penis to the ventral surface of the penis, scrotum, or perineum. Evidence: PCS. Frequency: 1/1. (PMID:31804630)
- Autosomal dominant inheritance (HP:0000006, a Human Phenotype Ontology term): A mode of inheritance that is observed for traits related to a gene encoded on one of the autosomes (i.e., the human chromosomes 1-22) in which a trait manifests in heterozygotes. In the context of medical genetics, an autosomal dominant disorder is caused when a single copy of the mutant allele is present. Males and females are affected equally, and can both transmit the disorder with a risk of 50% for each child of inheriting the mutant allele. Evidence: PCS. (PMID:31804630)
- Intellectual disability (HP:0001249, a Human Phenotype Ontology term): The term intellectual disability or intellectual developmental disorder is used to describe significantly sub-average intellectual and adaptive functioning based on clinical assessment and as measured by individually administered, appropriately normed, standardized and validated tests of intellectual functioning and adaptive behavior, with onset during the developmental period from infancy through adolescence. Evidence: PCS. Frequency: 1/1. (PMID:31804630)